- Coiled sperm flagella (HP:0032560): Sperm cells whose flagella are twisted (coiled). Evidence: PCS. Frequency: 2/2. (PMID:35228300)
- Reduced progressive sperm motility (HP:0034011): A reduced proportion of sperm that move in a straight line or large circles; alternatively, an increased proportion of sperm that move in tight circles or in some other non-linear fashion. Evidence: PCS. Frequency: 2/2. (PMID:35228300)
- Male infertility (HP:0003251). Evidence: PCS. Frequency: 2/2. (PMID:35228300)
- Young adult onset (HP:0011462): Onset of disease at the age of between 16 and 40 years. Evidence: PCS. Frequency: 2/2. (PMID:35228300)
- Autosomal recessive inheritance (HP:0000007): A mode of inheritance that is observed for traits related to a gene encoded on one of the autosomes (i.e., the human chromosomes 1-22) in which a trait manifests in individuals with two pathogenic alleles, either homozygotes (two copies of the same mutant allele) or compound heterozygotes (whereby each copy of a gene has a distinct mutant allele). Evidence: PCS. (PMID:35228300)
- Absent sperm flagella (HP:0032558): Sperm cells lacking flagella. Evidence: PCS. Frequency: 2/2. (PMID:35228300)
- Short sperm flagella (HP:0032559): Sperm cells with abnormally short flagella. Evidence: PCS. Frequency: 2/2. (PMID:35228300)
These phenotypes are associated with the disease spermatogenic failure 82 (OMIM:620353).